Phenotypes associated with the disease Palmoplantar keratoderma, Nagashima type (ORPHA:140966, an Orphanet rare-disease identifier):
- Hyperhidrosis (HP:0000975, a Human Phenotype Ontology term): Abnormal excessive perspiration (sweating) despite the lack of appropriate stimuli like hot and humid weather. Evidence: TAS. Frequency: Very frequent (HP:0040281, a Human Phenotype Ontology term). (ORPHA:140966)
- Palmoplantar keratoderma (HP:0000982, a Human Phenotype Ontology term): Abnormal thickening of the skin of the palms of the hands and the soles of the feet. Evidence: TAS. Frequency: Very frequent (HP:0040281, a Human Phenotype Ontology term). (ORPHA:140966)